Phenotypes associated with the disease hearing loss, autosomal recessive 112 (OMIM:618257):
- Sensorineural hearing impairment (HP:0000407): A type of hearing impairment in one or both ears related to an abnormal functionality of the cochlear nerve. Evidence: PCS. Frequency: 4/4. (PMID:24312468)
- Childhood onset (HP:0011463): Onset of disease at the age of between 1 and 5 years. Evidence: PCS. Frequency: 4/4. (PMID:24312468)
- Autosomal recessive inheritance (HP:0000007): A mode of inheritance that is observed for traits related to a gene encoded on one of the autosomes (i.e., the human chromosomes 1-22) in which a trait manifests in individuals with two pathogenic alleles, either homozygotes (two copies of the same mutant allele) or compound heterozygotes (whereby each copy of a gene has a distinct mutant allele). Evidence: PCS. (PMID:24312468)